- Facial erythema (HP:0001041): Redness of the skin of the face, caused by hyperemia of the capillaries in the lower layers of the skin. Evidence: TAS. Frequency: Very frequent (HP:0040281). (ORPHA:3406)
- Sparse lateral eyebrow (HP:0005338): Decreased density/number and/or decreased diameter of lateral eyebrow hairs. Evidence: TAS. Frequency: Very frequent (HP:0040281). (ORPHA:3406)
- Follicular hyperkeratosis (HP:0007502): A skin condition characterized by excessive development of keratin in hair follicles, resulting in rough, cone-shaped, elevated papules resulting from closure of hair follicles with a white plug of sebum. Evidence: TAS. Frequency: Very frequent (HP:0040281). (ORPHA:3406)
- Erythematous papule (HP:0030350): A circumscribed, solid elevation of skin with no visible fluid that is reddish (erythematous) in color. Evidence: TAS. Frequency: Very frequent (HP:0040281). (ORPHA:3406)
- Keratosis pilaris (HP:0032152): An anomaly of the hair follicles of the skin that typically presents as small, rough, brown folliculocentric papules distributed over characteristic areas of the skin, particularly the outer-upper arms and thighs. Evidence: TAS. Frequency: Very frequent (HP:0040281). (ORPHA:3406)
- Hyperkeratotic papule (HP:0045059): A circumscribed, solid elevation of skin with no visible fluid, varying in size from a pinhead to less than 10mm in diameter at the widest point that is composed of localized hyperkeratosis (the latter may be demonstrated histopathologically). Evidence: TAS. Frequency: Very frequent (HP:0040281). (ORPHA:3406)
- Abnormal forehead morphology (HP:0000290): An anomaly of the forehead. Evidence: TAS. Frequency: Frequent (HP:0040282). (ORPHA:3406)
- Abnormality of the chin (HP:0000306): An abnormality of the chin, i.e., of the inferior portion of the face lying inferior to the lower lip and including the central prominence of the lower jaw. Evidence: TAS. Frequency: Frequent (HP:0040282). (ORPHA:3406)
- Dry skin (HP:0000958): Skin characterized by the lack of natural or normal moisture. Evidence: TAS. Frequency: Frequent (HP:0040282). (ORPHA:3406)
- Dermal atrophy (HP:0004334): Partial or complete wasting (atrophy) of the skin. Evidence: TAS. Frequency: Frequent (HP:0040282). (ORPHA:3406)
- Abnormal cheek morphology (HP:0004426): An abnormality of the cheek- one of two bilateral soft tissue facial structures in the region of the face inferior to the eyes and between the nose and the ear. "Buccal" means relating to the cheek. The cheek is part of the midface. Evidence: TAS. Frequency: Frequent (HP:0040282). (ORPHA:3406)
- Acne (HP:0001061): A skin condition in which there is an increase in sebum secretion by the pilosebaceous apparatus associated with open comedones (blackheads), closed comedones (whiteheads), and pustular nodules (papules, pustules, and cysts). Evidence: TAS. Frequency: Occasional (HP:0040283). (ORPHA:3406)
- Miscarriage (HP:0005268): A pregnancy that ends at a stage in which the fetus is incapable of surviving on its own, defined as the spontaneous loss of a fetus before the 22th week of pregnancy. Evidence: TAS. Frequency: Occasional (HP:0040283). (ORPHA:3406)
- Contact dermatitis (HP:0032282): An inflammatory process in skin caused by an exogenous agent that directly or indirectly injure the skin. If the offending agent is identified and removed, the eruption will resolve. An unusual or patterned eruption may be a clue to the presence of a contact dermatitis. Patch testing may be helpful in the differential diagnosis. Evidence: TAS. Frequency: Occasional (HP:0040283). (ORPHA:3406)
These phenotypes are associated with the disease Ulerythema ophryogenesis (ORPHA:3406).